- Glaucoma (HP:0000501): Glaucoma refers loss of retinal ganglion cells in a characteristic pattern of optic neuropathy usually associated with increased intraocular pressure. Evidence: TAS. Frequency: Occasional (HP:0040283). (ORPHA:1160)
- Lymphedema (HP:0001004): Localized fluid retention and tissue swelling caused by a compromised lymphatic system. Evidence: TAS. Frequency: Very frequent (HP:0040281). (ORPHA:1160)
- Subcutaneous nodule (HP:0001482): Slightly elevated lesions on or in the skin with a diameter of over 5 mm. Evidence: TAS. Frequency: Frequent (HP:0040282). (ORPHA:1160)
- Ascites (HP:0001541): Accumulation of fluid in the peritoneal cavity (between the layers of the peritoneum that lines the abdomen). Evidence: TAS. Frequency: Very frequent (HP:0040281). (ORPHA:1160)
- Pancreatitis (HP:0001733): The presence of inflammation in the pancreas. Evidence: TAS. Frequency: Occasional (HP:0040283). (ORPHA:1160)
- Abnormal intestine morphology (HP:0002242): An abnormality of the intestine. The closely related term enteropathy is used to refer to any disease of the intestine. Evidence: TAS. Frequency: Occasional (HP:0040283). (ORPHA:1160)
- Neoplasm (HP:0002664): An organ or organ-system abnormality that consists of uncontrolled autonomous cell-proliferation which can occur in any part of the body as a benign or malignant neoplasm (tumor). Evidence: TAS. Frequency: Occasional (HP:0040283). (ORPHA:1160)
These phenotypes are associated with the disease Chylous ascites (ORPHA:1160).